Phenotypes associated with the disease developmental delay, behavioral abnormalities, and neuropsychiatric disorders (OMIM:620065):
- Delayed speech and language development (HP:0000750): A degree of language development that is significantly below the norm for a child of a specified age. Evidence: PCS. Frequency: 5/10. (PMID:35907405)
- Delayed ability to walk (HP:0031936): A failure to achieve the ability to walk at an appropriate developmental stage. Most children learn to walk in a series of stages, and learn to walk short distances independently between 12 and 15 months. Evidence: PCS. Frequency: 3/7. (PMID:35907405)
- Hypermetropia (HP:0000540): An abnormality of refraction characterized by the ability to see objects in the distance clearly, while objects nearby appear blurry. Evidence: PCS. Frequency: 1/10. (PMID:35907405)
- Seizure (HP:0001250): A seizure is an intermittent abnormality of nervous system physiology characterized by a transient occurrence of signs and/or symptoms due to abnormal excessive or synchronous neuronal activity in the brain. Evidence: PCS. Frequency: 2/9. (PMID:35907405)
- Joint hypermobility (HP:0001382): The capability that a joint (or a group of joints) has to move, passively and/or actively, beyond normal limits along physiological axes. Evidence: PCS. Frequency: 4/8. (PMID:35907405)
- Global developmental delay (HP:0001263): A delay in the achievement of motor or mental milestones in the domains of development of a child, including motor skills, speech and language, cognitive skills, and social and emotional skills. This term should only be used to describe children younger than five years of age. Evidence: PCS. Frequency: 9/10. (PMID:35907405)
- Hypotonia (HP:0001252): Hypotonia is an abnormally low muscle tone (the amount of tension or resistance to movement in a muscle). Even when relaxed, muscles have a continuous and passive partial contraction which provides some resistance to passive stretching. Hypotonia thus manifests as diminished resistance to passive stretching. Hypotonia is not the same as muscle weakness, although the two conditions can co-exist. Evidence: PCS. Frequency: 4/9. (PMID:35907405)
- Sleep disturbance (HP:0002360): An abnormal pattern in the quality, quantity, or characteristics of sleep. Evidence: PCS. Frequency: 5/9. (PMID:35907405)
- Periventricular nodular heterotopia (HP:0032388): Nodules of heterotopia along the ventricular walls. There can be a single nodule or a large number of nodules, they can exist on either or both sides of the brain at any point along the higher ventricle margins, they can be small or large, single or multiple. Evidence: PCS. Frequency: 1/5. (PMID:35907405)
- Autistic behavior (HP:0000729): Persistent deficits in social interaction and communication and interaction as well as a markedly restricted repertoire of activity and interest as well as repetitive patterns of behavior. Evidence: PCS. Frequency: 4/9. (PMID:35907405)
- Motor stereotypy (HP:0000733): Use of the same abnormal action in response to certain triggers or at random. They may be used as a way to regulate one's internal state but must otherwise have no apparent functional purpose. Evidence: PCS. Frequency: 2/8. (PMID:35907405)
- Overweight (HP:0025502): Increased body weight with a body mass index of 25-29.9 kg per square meter. Evidence: PCS. Frequency: 4/9. (PMID:35907405)
- Delayed ability to sit (HP:0025336): A failure to achieve the ability to sit at an appropriate developmental stage. Most children sit with support at 6 months of age and sit steadily without support at 9 months of age. Evidence: PCS. Frequency: 4/7. (PMID:35907405)
- Attention deficit hyperactivity disorder (HP:0007018): Attention deficit hyperactivity disorder (ADHD) manifests at age 2-3 years or by first grade at the latest. The main symptoms are distractibility, impulsivity, hyperactivity, and often trouble organizing tasks and projects, difficulty going to sleep, and social problems from being aggressive, loud, or impatient. Evidence: PCS. Frequency: 4/9. (PMID:35907405)
- Macrocephaly (HP:0000256): Occipitofrontal (head) circumference greater than 97th centile compared to appropriate, age matched, sex-matched normal standards. Alternatively, a apparently increased size of the cranium. Evidence: PCS. Frequency: 4/6. (PMID:35907405)
- Autosomal dominant inheritance (HP:0000006): A mode of inheritance that is observed for traits related to a gene encoded on one of the autosomes (i.e., the human chromosomes 1-22) in which a trait manifests in heterozygotes. In the context of medical genetics, an autosomal dominant disorder is caused when a single copy of the mutant allele is present. Males and females are affected equally, and can both transmit the disorder with a risk of 50% for each child of inheriting the mutant allele. Evidence: PCS. (PMID:35907405)
- Intellectual disability (HP:0001249): The term intellectual disability or intellectual developmental disorder is used to describe significantly sub-average intellectual and adaptive functioning based on clinical assessment and as measured by individually administered, appropriately normed, standardized and validated tests of intellectual functioning and adaptive behavior, with onset during the developmental period from infancy through adolescence. Evidence: PCS. Frequency: 5/10. (PMID:35907405)